- Alopecia universalis (HP:0002289): Loss of all hair on the entire body. Evidence: PCS. Frequency: 11/11. Onset: Neonatal onset (HP:0003623). (PMID:9445480)
- Absent eyebrow (HP:0002223): Absence of the eyebrow. Evidence: PCS. Frequency: 11/11. (PMID:9445480)
- Absent eyelashes (HP:0000561): Lack of eyelashes. Evidence: PCS. Frequency: 11/11. (PMID:9445480)
- Absent axillary hair (HP:0002221): Absence of axillary hair. Evidence: PCS. Frequency: 11/11. (PMID:9445480)
- Autosomal recessive inheritance (HP:0000007): A mode of inheritance that is observed for traits related to a gene encoded on one of the autosomes (i.e., the human chromosomes 1-22) in which a trait manifests in individuals with two pathogenic alleles, either homozygotes (two copies of the same mutant allele) or compound heterozygotes (whereby each copy of a gene has a distinct mutant allele). Evidence: PCS. (PMID:9445480)
- Absent pubic hair (HP:0002555): Absence of pubic hair. Evidence: PCS. Frequency: 11/11. (PMID:9445480)
- Neonatal onset (HP:0003623): Onset of signs or symptoms of disease within the first 28 days of life. Evidence: PCS. Frequency: 11/11. (PMID:9445480)
These phenotypes are associated with the disease alopecia universalis congenita (OMIM:203655).